- Epicanthus (HP:0000286): A fold of skin starting above the medial aspect of the upper eyelid and arching downward to cover, pass in front of and lateral to the medial canthus. Evidence: PCS. Frequency: 1/4. (PMID:20685673)
- Upslanted palpebral fissure (HP:0000582): The palpebral fissure inclination is more than two standard deviations above the mean for age (objective); or, the inclination of the palpebral fissure is greater than typical for age. Evidence: TAS. (OMIM:613544)
- Congenital onset (HP:0003577): A phenotypic abnormality that is present at birth. Evidence: PCS. Frequency: 5/5. (PMID:3351912;PMID:20685673)
- Long philtrum (HP:0000343): Distance between nasal base and midline upper lip vermilion border more than 2 SD above the mean. Alternatively, an apparently increased distance between nasal base and midline upper lip vermilion border. Evidence: PCS. Frequency: 4/4. (PMID:20685673)
- Short stature (HP:0004322): A height below that which is expected according to age and gender norms. Although there is no universally accepted definition of short stature, many refer to "short stature" as height more than 2 standard deviations below the mean for age and gender (or below the 3rd percentile for age and gender dependent norms). Evidence: TAS. (OMIM:613544)
- Inguinal hernia (HP:0000023): Protrusion of the contents of the abdominal cavity through the inguinal canal. Evidence: PCS. Frequency: 1/4. (PMID:20685673)
- Short nose (HP:0003196): Distance from nasion to subnasale more than two standard deviations below the mean, or alternatively, an apparently decreased length from the nasal root to the nasal tip. Evidence: TAS. (OMIM:613544)
- Hypotonia (HP:0001252): Hypotonia is an abnormally low muscle tone (the amount of tension or resistance to movement in a muscle). Even when relaxed, muscles have a continuous and passive partial contraction which provides some resistance to passive stretching. Hypotonia thus manifests as diminished resistance to passive stretching. Hypotonia is not the same as muscle weakness, although the two conditions can co-exist. Evidence: PCS. Frequency: 4/4. (PMID:20685673)
- Smooth philtrum (HP:0000319): Flat skin surface, with no ridge formation in the central region of the upper lip between the nasal base and upper vermilion border. Evidence: PCS. Frequency: 5/5. (PMID:3351912;PMID:20685673)
- Single transverse palmar crease (HP:0000954): The distal and proximal transverse palmar creases are merged into a single transverse palmar crease. Evidence: TAS. (OMIM:613544)
- Hypertelorism (HP:0000316): Interpupillary distance more than 2 SD above the mean (alternatively, the appearance of an increased interpupillary distance or widely spaced eyes). Evidence: TAS. (OMIM:613544)
- Thin upper lip vermilion (HP:0000219): Height of the vermilion of the upper lip in the midline more than 2 SD below the mean. Alternatively, an apparently reduced height of the vermilion of the upper lip in the frontal view (subjective). Evidence: PCS. Frequency: 5/5. (PMID:3351912;PMID:20685673)
- High palate (HP:0000218): Height of the palate more than 2 SD above the mean (objective) or palatal height at the level of the first permanent molar more than twice the height of the teeth (subjective). Evidence: PCS. Frequency: 3/3. (PMID:20685673;PMID:3351912)
- Sporadic (HP:0003745): Cases of the disease in question occur without a previous family history, i.e., as isolated cases without being transmitted from a parent and without other siblings being affected. Evidence: TAS. (OMIM:613544)
- Broad nasal tip (HP:0000455): Increase in width of the nasal tip. Evidence: TAS. (OMIM:613544)
- Pes planus (HP:0001763): A foot where the longitudinal arch of the foot is in contact with the ground or floor when the individual is standing; or, in a patient lying supine, a foot where the arch is in contact with the surface of a flat board pressed against the sole of the foot by the examiner with a pressure similar to that expected from weight bearing; or, the height of the arch is reduced. Evidence: PCS. Frequency: 1/1. (PMID:3351912)
- Abnormally high-pitched voice (HP:0001620): A persistent (minutes to hours) abnormal increase in the pitch (frequency) of the voice for the context or social situation or significantly different from baseline of the individual. Evidence: PCS. Frequency: 1/4. (PMID:20685673)
- Microcephaly (HP:0000252): Head circumference below 2 standard deviations below the mean for age and gender. Evidence: PCS. Frequency: 0/4. (PMID:20685673)
- Talipes equinovarus (HP:0001762): Talipes equinovarus (also called clubfoot) typically has four main components: inversion and adduction of the forefoot; inversion of the heel and hindfoot; equinus (limitation of extension) of the ankle and subtalar joint; and internal rotation of the leg. Evidence: PCS. Frequency: 1/4. (PMID:20685673)
- Pes cavus (HP:0001761): An increase in height of the medial longitudinal arch of the foot that does not flatten on weight bearing (i.e., a distinctly hollow form of the sole of the foot when it is bearing weight). Evidence: PCS. Frequency: 1/4. (PMID:20685673)
- Feeding difficulties (HP:0011968): Impaired ability to eat related to problems gathering food and getting ready to suck, chew, or swallow it. Evidence: PCS. Frequency: 1/1. (PMID:3351912)
- Joint hypermobility (HP:0001382): The capability that a joint (or a group of joints) has to move, passively and/or actively, beyond normal limits along physiological axes. Evidence: PCS. Frequency: 4/4. (PMID:20685673)
- Global developmental delay (HP:0001263): A delay in the achievement of motor or mental milestones in the domains of development of a child, including motor skills, speech and language, cognitive skills, and social and emotional skills. This term should only be used to describe children younger than five years of age. Evidence: PCS. Frequency: 5/5. (PMID:3351912;PMID:20685673)
- Short neck (HP:0000470): Diminished length of the neck. Evidence: PCS. Frequency: 1/1. (PMID:3351912)
- Low anterior hairline (HP:0000294): Distance between the hairline (trichion) and the glabella (the most prominent point on the frontal bone above the root of the nose), in the midline, more than two SD below the mean. Alternatively, an apparently decreased distance between the hairline and the glabella. Evidence: PCS. Frequency: 1/1. (PMID:20685673)
- Primary microcephaly (HP:0011451): Head circumference below 2 standard deviations below the mean for age and gender at birth. Evidence: PCS. Frequency: 1/1. (PMID:3351912)
- Umbilical hernia (HP:0001537): Protrusion of abdominal contents through a defect in the abdominal wall musculature around the umbilicus. Skin and subcutaneous tissue overlie the defect. Evidence: PCS. Frequency: 2/5. (PMID:3351912;PMID:20685673)
- Prominent nasal bridge (HP:0000426): Anterior positioning of the nasal root in comparison to the usual positioning for age. Evidence: PCS. Frequency: 2/2. (PMID:20685673)
- Hypotelorism (HP:0000601): Interpupillary distance less than 2 SD below the mean (alternatively, the appearance of an decreased interpupillary distance or closely spaced eyes). Evidence: TAS. Frequency: Occasional (HP:0040283). (OMIM:613544)
- Bilateral cryptorchidism (HP:0008689): Absence of both testes from the scrotum owing to failure of the testis or testes to descend through the inguinal canal to the scrotum. Evidence: PCS. Frequency: 1/1. (PMID:3351912)
- Sacral dimple (HP:0000960): A cutaneous indentation resulting from tethering of the skin to underlying structures (bone) of the intergluteal cleft. Evidence: PCS. Frequency: 2/4. (PMID:20685673)
- Low-set ears (HP:0000369): Upper insertion of the ear to the scalp below an imaginary horizontal line drawn between the inner canthi of the eye and extending posteriorly to the ear. Evidence: PCS. Frequency: 3/3. (PMID:20685673)
- Micrognathia (HP:0000347): Developmental hypoplasia of the mandible. Evidence: PCS. Frequency: 1/1. (PMID:3351912)
These phenotypes are associated with the disease chromosome 6q11-q14 deletion syndrome (OMIM:613544).